- Ganglioneuroma (HP:0003005): A benign neoplasm that usually arises from the sympathetic trunk in the mediastinum, representing a tumor of the sympathetic nerve fibers arising from neural crest cells. Evidence: TAS. Frequency: Very frequent (HP:0040281). (ORPHA:251937)
- Headache (HP:0002315): Cephalgia, or pain sensed in various parts of the head, not confined to the area of distribution of any nerve. Evidence: TAS. Frequency: Frequent (HP:0040282). (ORPHA:251937)
- Spinal cord tumor (HP:0010302): A neoplasm affecting the spinal cord. Evidence: TAS. Frequency: Frequent (HP:0040282). (ORPHA:251937)
- Hemianopia (HP:0012377): Partial or complete loss of vision in one half of the visual field of one or both eyes. Evidence: TAS. Frequency: Frequent (HP:0040282). (ORPHA:251937)
- Neoplasm of the central nervous system (HP:0100006): A neoplasm of the central nervous system. Evidence: TAS. Frequency: Frequent (HP:0040282). (ORPHA:251937)
- Amenorrhea (HP:0000141): Absence of menses for an interval of time equivalent to a total of more than (or equal to) 3 previous cycles or 6 months. Evidence: TAS. Frequency: Occasional (HP:0040283). (ORPHA:251937)
- Impotence (HP:0000802): Inability to develop or maintain an erection of the penis. Evidence: TAS. Frequency: Occasional (HP:0040283). (ORPHA:251937)
- Elevated circulating growth hormone concentration (HP:0000845): Acromegaly is a condition resulting from overproduction of growth hormone by the pituitary gland in persons with closed epiphyses, and consists chiefly in the enlargement of the distal parts of the body. The circumference of the skull increases, the nose becomes broad, the tongue becomes enlarged, the facial features become coarsened, the mandible grows excessively, and the teeth become separated. The fingers and toes grow chiefly in thickness. Evidence: TAS. Frequency: Occasional (HP:0040283). (ORPHA:251937)
- Hyperhidrosis (HP:0000975): Abnormal excessive perspiration (sweating) despite the lack of appropriate stimuli like hot and humid weather. Evidence: TAS. Frequency: Occasional (HP:0040283). (ORPHA:251937)
- Abnormal brainstem morphology (HP:0002363): An anomaly of the brainstem. Evidence: TAS. Frequency: Occasional (HP:0040283). (ORPHA:251937)
- Distal muscle weakness (HP:0002460): Reduced strength of the musculature of the distal extremities. Evidence: TAS. Frequency: Occasional (HP:0040283). (ORPHA:251937)
- Scoliosis (HP:0002650): The presence of an abnormal lateral curvature of the spine. Evidence: TAS. Frequency: Occasional (HP:0040283). (ORPHA:251937)
- Paresthesia (HP:0003401): Abnormal sensations such as tingling, pricking, or numbness of the skin with no apparent physical cause. Evidence: TAS. Frequency: Occasional (HP:0040283). (ORPHA:251937)
- Accelerated skeletal maturation (HP:0005616): An abnormally increased rate of skeletal maturation. Accelerated skeletal maturation can be diagnosed on the basis of an estimation of the bone age from radiographs of specific bones in the human body. Evidence: TAS. Frequency: Occasional (HP:0040283). (ORPHA:251937)
- Focal-onset seizure (HP:0007359): A focal-onset seizure is a type of seizure originating within networks limited to one hemisphere. They may be discretely localized or more widely distributed, and may originate in subcortical structures. Evidence: TAS. Frequency: Occasional (HP:0040283). (ORPHA:251937)
- Adrenocorticotropic hormone excess (HP:0011749): Overproduction of adrenocorticotropic hormone (ACTH), which generally leads secondarily to overproduction of cortisol by the adrenal cortex. Evidence: TAS. Frequency: Occasional (HP:0040283). (ORPHA:251937)
- Pituitary null cell adenoma (HP:0011761): A type of pituitary adenoma that is of unknown cellular origin and that lacks immunocytochemical or fine structural markers. Null cell adenomas are not associated with hormone excess. Evidence: TAS. Frequency: Occasional (HP:0040283). (ORPHA:251937)
- Abnormal pituitary gland morphology (HP:0012503): An anomaly of the pituitary gland. Evidence: TAS. Frequency: Occasional (HP:0040283). (ORPHA:251937)
- Decreased female libido (HP:0030018): Diminished sexual desire in female. Evidence: TAS. Frequency: Occasional (HP:0040283). (ORPHA:251937)
- Abnormal prolactin level (HP:0040086). Evidence: TAS. Frequency: Occasional (HP:0040283). (ORPHA:251937)
- Dementia (HP:0000726): A loss of global cognitive ability of sufficient amount to interfere with normal social or occupational function. Dementia represents a loss of previously present cognitive abilities, generally in adults, and can affect memory, thinking, language, judgment, and behavior. Evidence: TAS. Frequency: Very rare (HP:0040284). (ORPHA:251937)
- Excessive daytime somnolence (HP:0001262): A state of abnormally strong desire for sleep during the daytime. Evidence: TAS. Frequency: Very rare (HP:0040284). (ORPHA:251937)
- Abnormal cerebellum morphology (HP:0001317): Any structural abnormality of the cerebellum. Evidence: TAS. Frequency: Very rare (HP:0040284). (ORPHA:251937)
- Polyphagia (HP:0002591): A neurological anomaly with gross overeating associated with an abnormally strong desire or need to eat. Evidence: TAS. Frequency: Very rare (HP:0040284). (ORPHA:251937)
- Syringomyelia (HP:0003396): Dilated, glial-lined cavity in spinal cord. This cavity does not communicate with the central canal, and usually is between the dorsal columns unilaterally or bilaterally along the side of the cord. Evidence: TAS. Frequency: Very rare (HP:0040284). (ORPHA:251937)
- Pituitary prolactin cell adenoma (HP:0006767): A type of pituitary adenoma originating in prolactin secreting cells. This kind of adenoma is characterized by overproduction of prolactin, and may cause loss of menstrual periods and breast milk production in women. Evidence: TAS. Frequency: Very rare (HP:0040284). (ORPHA:251937)
These phenotypes are associated with the disease Gangliocytoma (ORPHA:251937).